Phenotypes associated with the disease cervical vertebral Bridge (OMIM:118000):
- Abnormality of the vertebral column (HP:0000925): Any abnormality of the vertebral column. Evidence: IEA. (OMIM:118000)
- Autosomal dominant inheritance (HP:0000006): A mode of inheritance that is observed for traits related to a gene encoded on one of the autosomes (i.e., the human chromosomes 1-22) in which a trait manifests in heterozygotes. In the context of medical genetics, an autosomal dominant disorder is caused when a single copy of the mutant allele is present. Males and females are affected equally, and can both transmit the disorder with a risk of 50% for each child of inheriting the mutant allele. Evidence: IEA. (OMIM:118000)